Phenotypes associated with the disease atrial fibrillation, familial, 8 (OMIM:613055):
- Adult onset (HP:0003581): Onset of disease manifestations in adulthood, defined here as at the age of 16 years or later. Evidence: PCS. (PMID:37449401)
- Atrial fibrillation (HP:0005110): An atrial arrhythmia characterized by disorganized atrial activity without discrete P waves on the surface EKG, but instead by an undulating baseline or more sharply circumscribed atrial deflections of varying amplitude an frequency ranging from 350 to 600 per minute. Evidence: PCS. (PMID:37449401)
- Autosomal dominant inheritance (HP:0000006): A mode of inheritance that is observed for traits related to a gene encoded on one of the autosomes (i.e., the human chromosomes 1-22) in which a trait manifests in heterozygotes. In the context of medical genetics, an autosomal dominant disorder is caused when a single copy of the mutant allele is present. Males and females are affected equally, and can both transmit the disorder with a risk of 50% for each child of inheriting the mutant allele. Evidence: PCS. (PMID:37449401)